- Intellectual disability (HP:0001249): The term intellectual disability or intellectual developmental disorder is used to describe significantly sub-average intellectual and adaptive functioning based on clinical assessment and as measured by individually administered, appropriately normed, standardized and validated tests of intellectual functioning and adaptive behavior, with onset during the developmental period from infancy through adolescence. Evidence: TAS. Frequency: Very frequent (HP:0040281). (ORPHA:280071)
- Seizure (HP:0001250): A seizure is an intermittent abnormality of nervous system physiology characterized by a transient occurrence of signs and/or symptoms due to abnormal excessive or synchronous neuronal activity in the brain. Evidence: TAS. Frequency: Very frequent (HP:0040281). (ORPHA:280071)
- Global developmental delay (HP:0001263): A delay in the achievement of motor or mental milestones in the domains of development of a child, including motor skills, speech and language, cognitive skills, and social and emotional skills. This term should only be used to describe children younger than five years of age. Evidence: TAS. Frequency: Very frequent (HP:0040281). (ORPHA:280071)
- Abnormal isoelectric focusing of serum transferrin (HP:0003160): Glycosylated transferrin concentrations can be measured in serum as a marker of N-linked glycosylation fidelity. In the traditional nomenclature for congenital disorders of glycosylation, absence of entire glycans was designated type I, and loss of one or more monosaccharides as type II. These terms are retained for historical reasons but for new annotations the precise glycosylation defect should be recorded. Evidence: TAS. Frequency: Very frequent (HP:0040281). (ORPHA:280071)
- Type I transferrin isoform profile (HP:0003642): Abnormal transferrin isoform profile consistent with a type I congenital disorder of glycosylation. In the traditional nomenclature for congenital disorders of glycosylation, absence of entire glycans was designated type I, and loss of one or more monosaccharides as type II. Evidence: TAS. Frequency: Very frequent (HP:0040281). (ORPHA:280071)
- Floppy infant (HP:0008947): Floppiness/hypotonia is defined as reduced resistance to passive movement of joints. Physical examination of floppy/hypotonic infants shows head lag, lack of shoulder and elbow muscle contraction on traction response, inability to tighten the shoulder girdle muscles (or slipping through) when held under the axillae, scarf sign (when the arm is pulled to the opposite side, the arm wraps around the neck with the elbow crossing midline), hyperdorsiflexion of the feet, easy apposition of the thumb against the forearm, feet touching the cheek with ease and without discomfort, frog leg position, and inverted U sign on ventral suspension (head, arms, and legs hanging down without elbow or knee flexion and the trunk rounded in a dome shape). Evidence: TAS. Frequency: Very frequent (HP:0040281). (ORPHA:280071)
- Reduced social responsiveness (HP:0012760): A reduced ability to participate in the back-and-forth flow of social interaction appropriate to culture and developmental level, which is normally characterized by an influence of the behavior of one person on the behavior of another person. This results in difficulty interacting with others through emotional, physical, or verbal communication. Evidence: TAS. Frequency: Very frequent (HP:0040281). (ORPHA:280071)
- Microcephaly (HP:0000252): Head circumference below 2 standard deviations below the mean for age and gender. Evidence: TAS. Frequency: Frequent (HP:0040282). (ORPHA:280071)
- Hearing impairment (HP:0000365): A decreased magnitude of the sensory perception of sound. Evidence: TAS. Frequency: Frequent (HP:0040282). (ORPHA:280071)
- Abnormality of vision (HP:0000504): Abnormality of eyesight (visual perception). Evidence: TAS. Frequency: Frequent (HP:0040282). (ORPHA:280071)
- Hypertonia (HP:0001276): A condition in which there is increased muscle tone so that arms or legs, for example, are stiff and difficult to move. Evidence: TAS. Frequency: Frequent (HP:0040282). (ORPHA:280071)
- Hyperreflexia (HP:0001347): Hyperreflexia is the presence of hyperactive stretch reflexes of the muscles. Evidence: TAS. Frequency: Frequent (HP:0040282). (ORPHA:280071)
- Abnormal facial shape (HP:0001999): An abnormal morphology (form) of the face or its components. Evidence: TAS. Frequency: Frequent (HP:0040282). (ORPHA:280071)
- Feeding difficulties (HP:0011968): Impaired ability to eat related to problems gathering food and getting ready to suck, chew, or swallow it. Evidence: TAS. Frequency: Frequent (HP:0040282). (ORPHA:280071)
- Retrognathia (HP:0000278): An abnormality in which the mandible is mislocalised posteriorly. Evidence: TAS. Frequency: Occasional (HP:0040283). (ORPHA:280071)
- Long philtrum (HP:0000343): Distance between nasal base and midline upper lip vermilion border more than 2 SD above the mean. Alternatively, an apparently increased distance between nasal base and midline upper lip vermilion border. Evidence: TAS. Frequency: Occasional (HP:0040283). (ORPHA:280071)
- High forehead (HP:0000348): An abnormally increased height of the forehead. Evidence: TAS. Frequency: Occasional (HP:0040283). (ORPHA:280071)
- Strabismus (HP:0000486): A misalignment of the eyes so that the visual axes deviate from bifoveal fixation. The classification of strabismus may be based on a number of features including the relative position of the eyes, whether the deviation is latent or manifest, intermittent or constant, concomitant or otherwise and according to the age of onset and the relevance of any associated refractive error. Evidence: TAS. Frequency: Occasional (HP:0040283). (ORPHA:280071)
- Dry skin (HP:0000958): Skin characterized by the lack of natural or normal moisture. Evidence: TAS. Frequency: Occasional (HP:0040283). (ORPHA:280071)
- Ataxia (HP:0001251): Ataxia refers to impaired coordination of voluntary muscle movement. Cerebellar ataxia refers to ataxia due to dysfunction of the cerebellum. This causes a variety of elementary neurological deficits including asynergy (lack of coordination between muscles, limbs and joints), dysmetria (lack of ability to judge distances that can lead to under- or overshoot in grasping movements), and dysdiadochokinesia (inability to perform rapid movements requiring antagonizing muscle groups to be switched on and off repeatedly). Evidence: TAS. Frequency: Occasional (HP:0040283). (ORPHA:280071)
- Failure to thrive (HP:0001508): Failure to thrive (FTT) refers to a child whose physical growth is substantially below the norm. Evidence: TAS. Frequency: Occasional (HP:0040283). (ORPHA:280071)
- Cerebral atrophy (HP:0002059): Atrophy (wasting, decrease in size of cells or tissue) affecting the cerebrum. Evidence: TAS. Frequency: Occasional (HP:0040283). (ORPHA:280071)
- Opisthotonus (HP:0002179): Opisthotonus is defined as a dramatic abnormal posture due to spastic contraction of the extensor muscles of the neck, trunk, and lower extremities that produces a severe backward arching from neck to heel. In most cases, the trunk is elevated off the ground by a few inches. It is usually sudden in onset and can be sustained or repetitive. It can be considered a variant of decerebrate posturing involving a hyperextension of the neck, back, and limbs. Evidence: TAS. Frequency: Occasional (HP:0040283). (ORPHA:280071)
- Gray matter heterotopia (HP:0002282): Heterotopia or neuronal heterotopia are macroscopic clusters of misplaced neurons (gray matter), most often situated along the ventricular walls or within the subcortical white matter. Evidence: TAS. Frequency: Occasional (HP:0040283). (ORPHA:280071)
- Hypokinesia (HP:0002375): Abnormally diminished motor activity. In contrast to paralysis, hypokinesia is not characterized by a lack of motor strength, but rather by a poverty of movement. The typical habitual movements (e.g., folding the arms, crossing the legs) are reduced in frequency. Evidence: TAS. Frequency: Occasional (HP:0040283). (ORPHA:280071)
- Abnormal cerebral white matter morphology (HP:0002500): An abnormality of the cerebral white matter. Evidence: TAS. Frequency: Occasional (HP:0040283). (ORPHA:280071)
- Limb hypertonia (HP:0002509). Evidence: TAS. Frequency: Occasional (HP:0040283). (ORPHA:280071)
- Episodic vomiting (HP:0002572): Paroxysmal, recurrent episodes of vomiting. Evidence: TAS. Frequency: Occasional (HP:0040283). (ORPHA:280071)
- Scoliosis (HP:0002650): The presence of an abnormal lateral curvature of the spine. Evidence: TAS. Frequency: Occasional (HP:0040283). (ORPHA:280071)
- Elevated circulating hepatic transaminase concentration (HP:0002910): Elevations of the levels of SGOT and SGPT in the serum. SGOT (serum glutamic oxaloacetic transaminase) and SGPT (serum glutamic pyruvic transaminase) are transaminases primarily found in the liver and heart and are released into the bloodstream as the result of liver or heart damage. SGOT and SGPT are used clinically mainly as markers of liver damage. Evidence: TAS. Frequency: Occasional (HP:0040283). (ORPHA:280071)
- Inverted nipples (HP:0003186): The presence of nipples that instead of pointing outward are retracted inwards. Evidence: TAS. Frequency: Occasional (HP:0040283). (ORPHA:280071)
- Temperature instability (HP:0005968): Disordered thermoregulation characterized by an impaired ability to maintain a balance between heat production and heat loss, with resulting instability of body temperature. Evidence: TAS. Frequency: Occasional (HP:0040283). (ORPHA:280071)
- Decreased corneal reflex (HP:0008000): An abnormally reduced response to stimulation of the cornea (by touch, foreign body, blowing air). The corneal reflex (also known as the blink reflex, normally results in an involuntary blinking of the eyelids. Evidence: TAS. Frequency: Occasional (HP:0040283). (ORPHA:280071)
- Axial hypotonia (HP:0008936): Muscular hypotonia (abnormally low muscle tone) affecting the musculature of the trunk. Evidence: TAS. Frequency: Occasional (HP:0040283). (ORPHA:280071)
- Abnormal adipose tissue morphology (HP:0009124): An abnormality of adipose tissue, which is loose connective tissue composed of adipocytes. Evidence: TAS. Frequency: Occasional (HP:0040283). (ORPHA:280071)
- EEG with burst suppression (HP:0010851): The burst suppression pattern in electroencephalography refers to a characteristic periodic pattern of low voltage (<10 microvolts) suppressed background and a relatively shorter pattern of higher amplitude slow, sharp, and spiking complexes. Evidence: TAS. Frequency: Occasional (HP:0040283). (ORPHA:280071)
- Abnormal skeletal morphology (HP:0011842): An abnormality of the form, structure, or size of the skeletal system. Evidence: TAS. Frequency: Occasional (HP:0040283). (ORPHA:280071)
- Delayed myelination (HP:0012448): Delayed myelination. Evidence: TAS. Frequency: Occasional (HP:0040283). (ORPHA:280071)
- Widened subarachnoid space (HP:0012704): An increase in size of the anatomic space between the arachnoid membrane and pia mater. Evidence: TAS. Frequency: Occasional (HP:0040283). (ORPHA:280071)
- Cerebral white matter atrophy (HP:0012762): The presence of atrophy (wasting) of the cerebral white matter. Evidence: TAS. Frequency: Occasional (HP:0040283). (ORPHA:280071)
These phenotypes are associated with the disease ALG11-CDG (ORPHA:280071).